Phenotypes associated with the disease pelvic organ prolapse, susceptibility to (OMIM:176780):
- Rectal prolapse (HP:0002035): Protrusion of the rectal mucous membrane through the anus. Evidence: IEA. (OMIM:176780)
- Bowel incontinence (HP:0002607): Involuntary fecal soiling in adults and children who have usually already been toilet trained. Evidence: IEA. (OMIM:176780)
- Autosomal dominant inheritance (HP:0000006): A mode of inheritance that is observed for traits related to a gene encoded on one of the autosomes (i.e., the human chromosomes 1-22) in which a trait manifests in heterozygotes. In the context of medical genetics, an autosomal dominant disorder is caused when a single copy of the mutant allele is present. Males and females are affected equally, and can both transmit the disorder with a risk of 50% for each child of inheriting the mutant allele. Evidence: IEA. (OMIM:176780)